- Bitemporal forceps marks (HP:0011336): Bilateral temporal scarlike defects, which are said to resemble forceps marks. Evidence: PCS. (PMID:19291768)
- Distichiasis (HP:0009743): Double rows of eyelashes. Evidence: PCS. (PMID:19291768)
- Autosomal dominant inheritance (HP:0000006): A mode of inheritance that is observed for traits related to a gene encoded on one of the autosomes (i.e., the human chromosomes 1-22) in which a trait manifests in heterozygotes. In the context of medical genetics, an autosomal dominant disorder is caused when a single copy of the mutant allele is present. Males and females are affected equally, and can both transmit the disorder with a risk of 50% for each child of inheriting the mutant allele. Evidence: PCS. (PMID:19291768)
- Low-set ears (HP:0000369): Upper insertion of the ear to the scalp below an imaginary horizontal line drawn between the inner canthi of the eye and extending posteriorly to the ear. Evidence: PCS. (PMID:19291768)
- Sparse lateral eyebrow (HP:0005338): Decreased density/number and/or decreased diameter of lateral eyebrow hairs. Evidence: PCS. (PMID:19291768)
These phenotypes are associated with the disease focal facial dermal dysplasia type I (OMIM:136500).